Phenotypes associated with the disease myofibromatosis, infantile, 2 (OMIM:615293):
- Myofibromatosis (HP:0020135): A mesenchymal neoplasm characterized by solitary or multiple nodules involving the skin, striated muscles, bones and, sometimes, viscera. It usually appears as a subcutaneous nodule, but can also appear as an ulcer, pedunculated lesion, or similar to a hemangioma. Histology shows well-circumscribed tapered cell lobes, resembling smooth muscle cells. At its center, perivascular round cells (hemangiopericitoides) are usually observed, giving a biphasic appearance. Evidence: PCS. (PMID:23731542)
- Autosomal dominant inheritance (HP:0000006): A mode of inheritance that is observed for traits related to a gene encoded on one of the autosomes (i.e., the human chromosomes 1-22) in which a trait manifests in heterozygotes. In the context of medical genetics, an autosomal dominant disorder is caused when a single copy of the mutant allele is present. Males and females are affected equally, and can both transmit the disorder with a risk of 50% for each child of inheriting the mutant allele. Evidence: PCS. (PMID:23731542)